- Abnormal dermatoglyphics (HP:0007477): An abnormality of dermatoglyphs (fingerprints), which are present on fingers, palms, toes, and soles. Evidence: TAS. (OMIM:125530)
- Autosomal dominant inheritance (HP:0000006): A mode of inheritance that is observed for traits related to a gene encoded on one of the autosomes (i.e., the human chromosomes 1-22) in which a trait manifests in heterozygotes. In the context of medical genetics, an autosomal dominant disorder is caused when a single copy of the mutant allele is present. Males and females are affected equally, and can both transmit the disorder with a risk of 50% for each child of inheriting the mutant allele. Evidence: TAS. (OMIM:125530)
These phenotypes are associated with the disease Dermal ridges, nelson syndrome (OMIM:125530).